Phenotypes associated with the disease nocturnal enuresis, 2 (OMIM:600808):
- Autosomal dominant inheritance (HP:0000006): A mode of inheritance that is observed for traits related to a gene encoded on one of the autosomes (i.e., the human chromosomes 1-22) in which a trait manifests in heterozygotes. In the context of medical genetics, an autosomal dominant disorder is caused when a single copy of the mutant allele is present. Males and females are affected equally, and can both transmit the disorder with a risk of 50% for each child of inheriting the mutant allele. Evidence: IEA. (OMIM:600808)
- Enuresis nocturna (HP:0010677): Enuresis occurring during sleeping hours. Evidence: TAS. (OMIM:600808)